- Sinusitis (HP:0000246): Inflammation of the paranasal sinuses owing to a viral, bacterial, or fungal infection, allergy, or an autoimmune reaction. Evidence: TAS. Frequency: Very frequent (HP:0040281). (ORPHA:229717)
- Otitis media (HP:0000388): Inflammation or infection of the middle ear. Evidence: TAS. Frequency: Very frequent (HP:0040281). (ORPHA:229717)
- Skin rash (HP:0000988): A red eruption of the skin. Evidence: TAS. Frequency: Very frequent (HP:0040281). (ORPHA:229717)
- Meningitis (HP:0001287): Inflammation of the meninges. Evidence: TAS. Frequency: Occasional (HP:0040283). (ORPHA:229717)
- Arthritis (HP:0001369): Inflammation of a joint. Evidence: TAS. Frequency: Occasional (HP:0040283). (ORPHA:229717)
- Failure to thrive (HP:0001508): Failure to thrive (FTT) refers to a child whose physical growth is substantially below the norm. Evidence: TAS. Frequency: Very frequent (HP:0040281). (ORPHA:229717)
- Clinodactyly of the 5th toe (HP:0001864): Bending or curvature of a fifth toe in the tibial direction (i.e., towards the big toe). Evidence: TAS. Frequency: Occasional (HP:0040283). (ORPHA:229717)
- Thrombocytopenia (HP:0001873): A reduction in the number of circulating thrombocytes. Evidence: TAS. Frequency: Occasional (HP:0040283). (ORPHA:229717)
- Abnormality of neutrophils (HP:0001874): A neutrophil abnormality. Evidence: TAS. Frequency: Frequent (HP:0040282). (ORPHA:229717)
- Anemia (HP:0001903): A reduction in erythrocytes volume or hemoglobin concentration. Evidence: TAS. Frequency: Occasional (HP:0040283). (ORPHA:229717)
- Fever (HP:0001945): Body temperature elevated above the normal range. Evidence: TAS. Frequency: Very frequent (HP:0040281). (ORPHA:229717)
- Abnormal facial shape (HP:0001999): An abnormal morphology (form) of the face or its components. Evidence: TAS. Frequency: Occasional (HP:0040283). (ORPHA:229717)
- Diarrhea (HP:0002014): Abnormally increased frequency (usually defined as three or more) loose or watery bowel movements a day. Evidence: TAS. Frequency: Very frequent (HP:0040281). (ORPHA:229717)
- Malabsorption (HP:0002024): Impaired ability to absorb one or more nutrients from the intestine. Evidence: TAS. Frequency: Occasional (HP:0040283). (ORPHA:229717)
- Pneumonia (HP:0002090): Inflammation of any part of the lung parenchyma. Evidence: TAS. Frequency: Frequent (HP:0040282). (ORPHA:229717)
- Recurrent respiratory infections (HP:0002205): An increased susceptibility to respiratory infections as manifested by a history of recurrent respiratory infections. Evidence: TAS. Frequency: Very frequent (HP:0040281). (ORPHA:229717)
- Immunodeficiency (HP:0002721): Failure of the immune system to protect the body adequately from infection, due to the absence or insufficiency of some component process or substance. Evidence: TAS. Frequency: Very frequent (HP:0040281). (ORPHA:229717)
- Autoimmunity (HP:0002960): The occurrence of an immune reaction against the organism's own cells or tissues. Evidence: TAS. Frequency: Occasional (HP:0040283). (ORPHA:229717)
- Short stature (HP:0004322): A height below that which is expected according to age and gender norms. Although there is no universally accepted definition of short stature, many refer to "short stature" as height more than 2 standard deviations below the mean for age and gender (or below the 3rd percentile for age and gender dependent norms). Evidence: TAS. Frequency: Occasional (HP:0040283). (ORPHA:229717)
- Abnormal lymphocyte morphology (HP:0004332): An abnormality of lymphocytes. Evidence: TAS. Frequency: Very frequent (HP:0040281). (ORPHA:229717)
- Fatigue (HP:0012378): A subjective feeling of tiredness characterized by a lack of energy and motivation. Evidence: TAS. Frequency: Very frequent (HP:0040281). (ORPHA:229717)
- Inflammatory abnormality of the eye (HP:0100533): Inflammation of the eye, parts of the eye or the periorbital region. Evidence: TAS. Frequency: Very frequent (HP:0040281). (ORPHA:229717)
- Cellulitis (HP:0100658): A bacterial infection and inflammation of the skin und subcutaneous tissues. Evidence: TAS. Frequency: Occasional (HP:0040283). (ORPHA:229717)
- Abnormality of the lymphatic system (HP:0100763): An anomaly of the lymphatic system, a network of lymphatic vessels that carry a clear fluid called lymph unidirectionally towards either the right lymphatic duct or the thoracic duct, which in turn drain into the right and left subclavian veins respectively. Evidence: TAS. Frequency: Frequent (HP:0040282). (ORPHA:229717)
- Abnormality of the tonsils (HP:0100765): An abnormality of the tonsils. Evidence: TAS. Frequency: Occasional (HP:0040283). (ORPHA:229717)
- Sepsis (HP:0100806): Sepsis is defined as life-threatening organ dysfunction caused by a dysregulated host response to infection. Evidence: TAS. Frequency: Occasional (HP:0040283). (ORPHA:229717)
- Recurrent cutaneous abscess formation (HP:0100838): An increased susceptibility to cutaneous abscess formation, as manifested by a medical history of recurrent cutaneous abscesses. Evidence: TAS. Frequency: Very frequent (HP:0040281). (ORPHA:229717)
- Skin ulcer (HP:0200042): A discontinuity of the skin exhibiting complete loss of the epidermis and often portions of the dermis and even subcutaneous fat. Evidence: TAS. Frequency: Very frequent (HP:0040281). (ORPHA:229717)
These phenotypes are associated with the disease Non-syndromic agammaglobulinemia (ORPHA:229717).